- Abnormal iris vasculature (HP:0007905). Evidence: IEA. (OMIM:137750)
- Autosomal dominant inheritance (HP:0000006): A mode of inheritance that is observed for traits related to a gene encoded on one of the autosomes (i.e., the human chromosomes 1-22) in which a trait manifests in heterozygotes. In the context of medical genetics, an autosomal dominant disorder is caused when a single copy of the mutant allele is present. Males and females are affected equally, and can both transmit the disorder with a risk of 50% for each child of inheriting the mutant allele. Evidence: IEA. (OMIM:137750)
- Glaucoma (HP:0000501): Glaucoma refers loss of retinal ganglion cells in a characteristic pattern of optic neuropathy usually associated with increased intraocular pressure. Evidence: IEA. (OMIM:137750)
- Myopia (HP:0000545): An abnormality of refraction characterized by the ability to see objects nearby clearly, while objects in the distance appear blurry. Evidence: IEA. (OMIM:137750)
These phenotypes are associated with the disease glaucoma 1, open angle, A (OMIM:137750).